- Dysarthria (HP:0001260): Dysarthric speech is a general description referring to a neurological speech disorder characterized by poor articulation. Depending on the involved neurological structures, dysarthria may be further classified as spastic, flaccid, ataxic, hyperkinetic and hypokinetic, or mixed. Evidence: TAS. Frequency: Very frequent (HP:0040281). (ORPHA:217012)
- Cerebellar atrophy (HP:0001272): Cerebellar atrophy is defined as a cerebellum with initially normal structures, in a posterior fossa with normal size, which displays enlarged fissures (interfolial spaces) in comparison to the foliae secondary to loss of tissue. Cerebellar atrophy implies irreversible loss of tissue and result from an ongoing progressive disease until a final stage is reached or a single injury, e.g. an intoxication or infectious event. Evidence: TAS. Frequency: Very frequent (HP:0040281). (ORPHA:217012)
- Gait ataxia (HP:0002066): A type of ataxia characterized by the impairment of the ability to coordinate the movements required for normal walking. Gait ataxia is characteirzed by a wide-based staggering gait with a tendency to fall. Evidence: TAS. Frequency: Very frequent (HP:0040281). (ORPHA:217012)
- Nystagmus (HP:0000639): Rhythmic, involuntary oscillations of one or both eyes related to abnormality in fixation, conjugate gaze, or vestibular mechanisms. Evidence: TAS. Frequency: Frequent (HP:0040282). (ORPHA:217012)
- Hyporeflexia (HP:0001265): Reduction of neurologic reflexes such as the knee-jerk reaction. Evidence: TAS. Frequency: Frequent (HP:0040282). (ORPHA:217012)
- Hearing impairment (HP:0000365): A decreased magnitude of the sensory perception of sound. Evidence: TAS. Frequency: Occasional (HP:0040283). (ORPHA:217012)
- Spasticity (HP:0001257): A motor disorder characterized by a velocity-dependent increase in tonic stretch reflexes with increased muscle tone, exaggerated (hyperexcitable) tendon reflexes. Evidence: TAS. Frequency: Occasional (HP:0040283). (ORPHA:217012)
- Tremor (HP:0001337): An unintentional, oscillating to-and-fro muscle movement about a joint axis. Evidence: TAS. Frequency: Occasional (HP:0040283). (ORPHA:217012)
- Hyperreflexia (HP:0001347): Hyperreflexia is the presence of hyperactive stretch reflexes of the muscles. Evidence: TAS. Frequency: Occasional (HP:0040283). (ORPHA:217012)
- Impaired vibratory sensation (HP:0002495): A decrease in the ability to perceive vibration. Clinically, this is usually tested with a tuning fork which vibrates at 128 Hz and is applied to bony prominences such as the malleoli at the ankles or the metacarpal-phalangeal joints. There is a slow decay of vibration from the tuning fork. The degree of vibratory sense loss can be crudely estimated by counting the number of seconds that the examiner can perceive the vibration longer than the patient. Evidence: TAS. Frequency: Occasional (HP:0040283). (ORPHA:217012)
- Hyperactive deep tendon reflexes (HP:0006801). Evidence: TAS. Frequency: Occasional (HP:0040283). (ORPHA:217012)
These phenotypes are associated with the disease Spinocerebellar ataxia type 31 (ORPHA:217012).